Phenotypes associated with the disease Ritscher-Schinzel syndrome 2 (OMIM:300963):
- Poor speech (HP:0002465). Evidence: PCS. Frequency: 2/2. (PMID:24916641)
- Upslanted palpebral fissure (HP:0000582): The palpebral fissure inclination is more than two standard deviations above the mean for age (objective); or, the inclination of the palpebral fissure is greater than typical for age. Evidence: PCS. Frequency: 2/2. (PMID:24916641)
- Prominent fingertip pads (HP:0001212): A soft tissue prominence of the ventral aspects of the fingertips. The term "persistent fetal fingertip pads" is often used as a synonym, but should better not be used because it implies knowledge of history of the patient which often does not exist. Evidence: PCS. Frequency: 2/2. (PMID:24916641)
- Wide anterior fontanel (HP:0000260): Enlargement of the anterior fontanelle with respect to age-dependent norms. Evidence: PCS. Frequency: 2/2. (PMID:24916641)
- Camptodactyly of finger (HP:0100490): The distal interphalangeal joint and/or the proximal interphalangeal joint of the fingers cannot be extended to 180 degrees by either active or passive extension. Evidence: PCS. Frequency: 2/2. (PMID:24916641)
- Protruding tongue (HP:0010808): Tongue extending beyond the alveolar ridges or teeth at rest. Evidence: PCS. Frequency: 2/2. (PMID:24916641)
- Hypotonia (HP:0001252): Hypotonia is an abnormally low muscle tone (the amount of tension or resistance to movement in a muscle). Even when relaxed, muscles have a continuous and passive partial contraction which provides some resistance to passive stretching. Hypotonia thus manifests as diminished resistance to passive stretching. Hypotonia is not the same as muscle weakness, although the two conditions can co-exist. Evidence: PCS. Frequency: 2/2. (PMID:24916641)
- Low posterior hairline (HP:0002162): Hair on the neck extends more inferiorly than usual. Evidence: PCS. Frequency: 2/2. (PMID:24916641)
- Relative macrocephaly (HP:0004482): A relatively mild degree of macrocephaly in which the head circumference is not above two standard deviations from the mean, but appears dysproportionately large when other factors such as body stature are taken into account. Evidence: PCS. Frequency: 2/2. (PMID:24916641)
- Ventricular septal defect (HP:0001629): A hole between the two bottom chambers (ventricles) of the heart. The defect is centered around the most superior aspect of the ventricular septum. Evidence: PCS. Frequency: 3/7. (PMID:24916641;PMID:21826058)
- Broad hallux (HP:0010055): Visible increase in width of the hallux without an increase in the dorso-ventral dimension. Evidence: PCS. Frequency: 2/2. (PMID:24916641)
- Arachnoid cyst (HP:0100702): An extra-parenchymal and intra-arachnoidal collection of fluid with a composition similar to that of cerebrospinal fluid. Evidence: PCS. Frequency: 1/5. (PMID:21826058)
- Short distal phalanx of finger (HP:0009882): Short distance from the end of the finger to the most distal interphalangeal crease or the distal interphalangeal joint flexion point. That is, hypoplasia of one or more of the distal phalanx of finger. Evidence: TAS. (OMIM:300963)
- Hypertelorism (HP:0000316): Interpupillary distance more than 2 SD above the mean (alternatively, the appearance of an increased interpupillary distance or widely spaced eyes). Evidence: PCS. Frequency: 14/14. (PMID:24916641;PMID:21826058)
- Overlapping toe (HP:0001845): Describes a foot digit resting on the dorsal surface of an adjacent digit when the foot is at rest. Initially clawing may be dynamic and only noticeable on walking. Over time the plantar plate tears, subluxation occurs at the metatarsophalangeal joint (MTPJ), and the deformity becomes permanent. Evidence: PCS. Frequency: 2/2. (PMID:24916641)
- Broad forehead (HP:0000337): Width of the forehead or distance between the frontotemporales is more than two standard deviations above the mean (objective); or apparently increased distance between the two sides of the forehead. Evidence: PCS. Frequency: 2/2. (PMID:24916641)
- Dandy-Walker malformation (HP:0001305): A congenital brain malformation typically characterized by incomplete formation of the cerebellar vermis, dilation of the fourth ventricle, and enlargement of the posterior fossa. In layman's terms, Dandy Walker malformation is a cyst in the cerebellum (typically symmetrical) that is involved with the fourth ventricle. This may interfere with the ability to drain cerebrospinal fluid from the brain, resulting in hydrocephalus. Dandy Walker cysts are formed during early embryonic development, while the brain forms. The cyst in the cerebellum typically has several blood vessels running through it connecting to the brain, thereby prohibiting surgical removal. Evidence: PCS. Frequency: 3/7. (PMID:24916641;PMID:21826058)
- Postnatal growth retardation (HP:0008897): Slow or limited growth after birth. Evidence: PCS. Frequency: 2/2. (PMID:24916641)
- High palate (HP:0000218): Height of the palate more than 2 SD above the mean (objective) or palatal height at the level of the first permanent molar more than twice the height of the teeth (subjective). Evidence: PCS. (PMID:21826058)
- Patent ductus arteriosus (HP:0001643): In utero, the ductus arteriosus (DA) serves to divert ventricular output away from the lungs and toward the placenta by connecting the main pulmonary artery to the descending aorta. A patent ductus arteriosus (PDA) in the first 3 days of life is a physiologic shunt in healthy term and preterm newborn infants, and normally is substantially closed within about 24 hours after bith and completely closed after about three weeks. Failure of physiologcal closure is referred to a persistent or patent ductus arteriosus (PDA). Depending on the degree of left-to-right shunting, PDA can have clinical consequences. Evidence: TAS. (OMIM:300963)
- Intellectual disability (HP:0001249): The term intellectual disability or intellectual developmental disorder is used to describe significantly sub-average intellectual and adaptive functioning based on clinical assessment and as measured by individually administered, appropriately normed, standardized and validated tests of intellectual functioning and adaptive behavior, with onset during the developmental period from infancy through adolescence. Evidence: PCS. Frequency: 5/7. (PMID:24916641;PMID:21826058)
- Broad neck (HP:0000475): Increased side-to-side width of the neck. Evidence: PCS. Frequency: 2/2. (PMID:24916641)
- Scoliosis (HP:0002650): The presence of an abnormal lateral curvature of the spine. Evidence: TAS. (OMIM:300963)
- Cerebellar hypoplasia (HP:0001321): Cerebellar hypoplasia is a descriptive term implying a cerebellum with a reduced volume, but a normal shape and is stable over time. Evidence: PCS. Frequency: 1/5. (PMID:21826058)
- Delayed ability to walk (HP:0031936): A failure to achieve the ability to walk at an appropriate developmental stage. Most children learn to walk in a series of stages, and learn to walk short distances independently between 12 and 15 months. Evidence: PCS. Frequency: 2/2. (PMID:24916641)
- Pulmonary artery hypoplasia (HP:0004971): Underdevelopment of the pulmonary artery. Evidence: PCS. Frequency: 1/5. (PMID:21826058)
- Global developmental delay (HP:0001263): A delay in the achievement of motor or mental milestones in the domains of development of a child, including motor skills, speech and language, cognitive skills, and social and emotional skills. This term should only be used to describe children younger than five years of age. Evidence: PCS. Frequency: 2/2. (PMID:24916641)
- Camptodactyly (HP:0012385): The distal interphalangeal joint and/or the proximal interphalangeal joint of the fingers or toes cannot be extended to 180 degrees by either active or passive extension. Evidence: PCS. Frequency: 2/2. (PMID:24916641)
- X-linked recessive inheritance (HP:0001419): A mode of inheritance that is observed for recessive traits related to a gene encoded on the X chromosome. In the context of medical genetics, X-linked recessive disorders manifest in males (who have one copy of the X chromosome and are thus hemizygotes), but generally not in female heterozygotes who have one mutant and one normal allele. Evidence: PCS. (PMID:21826058)
- Clinodactyly of the 5th finger (HP:0004209): Clinodactyly refers to a bending or curvature of the fifth finger in the radial direction (i.e., towards the 4th finger). Evidence: PCS. Frequency: 2/2. (PMID:24916641)
- Convex nasal ridge (HP:0000444): Nasal ridge curving anteriorly to an imaginary line that connects the nasal root and tip. The nose appears often also prominent, and the columella low. Evidence: PCS. (PMID:21826058)
- Syndactyly (HP:0001159): Webbing or fusion of the fingers or toes, involving soft parts only or including bone structure. Bony fusions are referred to as "bony" syndactyly if the fusion occurs in a radio-ulnar axis. Fusions of bones of the fingers or toes in a proximo-distal axis are referred to as "symphalangism". Evidence: TAS. (OMIM:300963)
- Atrial septal defect (HP:0001631): Atrial septal defect (ASD) is a congenital abnormality of the interatrial septum that enables blood flow between the left and right atria via the interatrial septum. Evidence: PCS. Frequency: 1/5. (PMID:21826058)
- Short philtrum (HP:0000322): Distance between nasal base and midline upper lip vermilion border more than 2 SD below the mean. Alternatively, an apparently decreased distance between nasal base and midline upper lip vermilion border. Evidence: PCS. Frequency: 2/2. (PMID:24916641)
- Cryptorchidism (HP:0000028): Testis in inguinal canal. That is, absence of one or both testes from the scrotum owing to failure of the testis or testes to descend through the inguinal canal to the scrotum. Evidence: PCS. Frequency: 4/7. (PMID:24916641;PMID:21826058)
- Glaucoma (HP:0000501): Glaucoma refers loss of retinal ganglion cells in a characteristic pattern of optic neuropathy usually associated with increased intraocular pressure. Evidence: PCS. Frequency: 1/2. (PMID:24916641)
- Intestinal malrotation (HP:0002566): An abnormality of the intestinal rotation and fixation that normally occurs during the development of the gut. This can lead to volvulus, or twisting of the intestine that causes obstruction and necrosis. Evidence: PCS. Frequency: 1/5. (PMID:21826058)